Phenotypes associated with the disease autosomal recessive nonsyndromic hearing loss 55 (OMIM:609952):
- Hearing impairment (HP:0000365): A decreased magnitude of the sensory perception of sound. Evidence: PCS. Frequency: 4/4. Onset: Infantile onset (HP:0003593). (PMID:16098016)
- Abnormal vestibular function (HP:0001751): An abnormality of the functioning of the vestibular apparatus. Evidence: PCS. Frequency: 0/4. (PMID:16098016)
- Autosomal recessive inheritance (HP:0000007): A mode of inheritance that is observed for traits related to a gene encoded on one of the autosomes (i.e., the human chromosomes 1-22) in which a trait manifests in individuals with two pathogenic alleles, either homozygotes (two copies of the same mutant allele) or compound heterozygotes (whereby each copy of a gene has a distinct mutant allele). Evidence: PCS. (PMID:16098016)
- Reduced visual acuity (HP:0007663). Evidence: PCS. Frequency: 0/4. (PMID:16098016)